- Polyhydramnios (HP:0001561): The presence of excess amniotic fluid in the uterus during pregnancy. Evidence: TAS. (OMIM:263610)
- Autosomal recessive inheritance (HP:0000007): A mode of inheritance that is observed for traits related to a gene encoded on one of the autosomes (i.e., the human chromosomes 1-22) in which a trait manifests in individuals with two pathogenic alleles, either homozygotes (two copies of the same mutant allele) or compound heterozygotes (whereby each copy of a gene has a distinct mutant allele). Evidence: TAS. (OMIM:263610)
These phenotypes are associated with the disease polyhydramnios, chronic idiopathic (OMIM:263610).